- Short finger (HP:0009381): Abnormally short finger associated with developmental hypoplasia. Evidence: TAS. (OMIM:604381)
- Brachydactyly (HP:0001156): Digits that appear disproportionately short compared to the hand/foot. The word brachydactyly is used here to describe a series distinct patterns of shortened digits (brachydactyly types A-E). This is the sense used here. Evidence: TAS. (OMIM:604381)
- Bicuspid aortic valve (HP:0001647): The presence of an aortic valve with two instead of the normal three cusps (flaps). Bicuspid aortic valvue is a malformation of a commissure (small space between the attachment of each cusp to the aortic wall) and the adjacent parts of the two corresponding cusps forming a raphe (the fused area of the two underdeveloped cusps turning into a malformed commissure between both cusps; the raphe is a fibrous ridge that extends from the commissure to the free edge of the two underdeveloped, conjoint cusps). Evidence: TAS. (OMIM:604381)
- Pseudocoarctation of the aorta (HP:0005295): Pseudocoarctation is a congenital anomaly of kinking, or buckling, of the aorta without a pressure gradient across the lesion. It is characterized by elongation and kinking of the aorta at the level of the ligamentum arteriosum. Evidence: TAS. (OMIM:604381)
- Short 5th metacarpal (HP:0010047): Short fifth metacarpal bone. Evidence: TAS. (OMIM:604381)
- Clinodactyly of the 5th finger (HP:0004209): Clinodactyly refers to a bending or curvature of the fifth finger in the radial direction (i.e., towards the 4th finger). Evidence: TAS. (OMIM:604381)
- Patent ductus arteriosus (HP:0001643): In utero, the ductus arteriosus (DA) serves to divert ventricular output away from the lungs and toward the placenta by connecting the main pulmonary artery to the descending aorta. A patent ductus arteriosus (PDA) in the first 3 days of life is a physiologic shunt in healthy term and preterm newborn infants, and normally is substantially closed within about 24 hours after bith and completely closed after about three weeks. Failure of physiologcal closure is referred to a persistent or patent ductus arteriosus (PDA). Depending on the degree of left-to-right shunting, PDA can have clinical consequences. Evidence: TAS. (OMIM:604381)
- Autosomal dominant inheritance (HP:0000006): A mode of inheritance that is observed for traits related to a gene encoded on one of the autosomes (i.e., the human chromosomes 1-22) in which a trait manifests in heterozygotes. In the context of medical genetics, an autosomal dominant disorder is caused when a single copy of the mutant allele is present. Males and females are affected equally, and can both transmit the disorder with a risk of 50% for each child of inheriting the mutant allele. Evidence: TAS. (OMIM:604381)
- Short toe (HP:0001831): A toe that appears disproportionately short compared to the foot. Evidence: TAS. (OMIM:604381)
These phenotypes are associated with the disease patent ductus arteriosus-bicuspid aortic valve-hand anomalies syndrome (OMIM:604381).